Phenotypes associated with the disease hereditary painful callosities (OMIM:114140):
- Autosomal dominant inheritance (HP:0000006): A mode of inheritance that is observed for traits related to a gene encoded on one of the autosomes (i.e., the human chromosomes 1-22) in which a trait manifests in heterozygotes. In the context of medical genetics, an autosomal dominant disorder is caused when a single copy of the mutant allele is present. Males and females are affected equally, and can both transmit the disorder with a risk of 50% for each child of inheriting the mutant allele. Evidence: IEA. (OMIM:114140)
- Abnormality of the skin (HP:0000951): An abnormality of the skin. Evidence: IEA. (OMIM:114140)